Phenotypes associated with the disease toes, relative length of first and second (OMIM:189200):
- Abnormality of the skeletal system (HP:0000924): An abnormality of the skeletal system. Evidence: IEA. (OMIM:189200)
- Autosomal dominant inheritance (HP:0000006): A mode of inheritance that is observed for traits related to a gene encoded on one of the autosomes (i.e., the human chromosomes 1-22) in which a trait manifests in heterozygotes. In the context of medical genetics, an autosomal dominant disorder is caused when a single copy of the mutant allele is present. Males and females are affected equally, and can both transmit the disorder with a risk of 50% for each child of inheriting the mutant allele. Evidence: IEA. (OMIM:189200)